Phenotypes associated with the disease premature ovarian failure 17 (OMIM:619146):
- Premature ovarian insufficiency (HP:0008209): Amenorrhea due to loss of ovarian function before the age of 40. Primary ovarian insuficiency (POI) is a state of female hypergonadotropic hypogonadism. It can manifest as primary amenorrhea with onset before menarche or secondary amenorrhea. Evidence: PCS. Frequency: 1/1. (PMID:30489636)
- Elevated circulating luteinizing hormone level (HP:0011969): An elevated concentration of luteinizing hormone in the blood. Evidence: PCS. Frequency: 1/1. (PMID:30489636)
- Young adult onset (HP:0011462): Onset of disease at the age of between 16 and 40 years. Evidence: PCS. Frequency: 1/1. (PMID:30489636)
- Elevated circulating follicle stimulating hormone level (HP:0008232): An elevated concentration of follicle-stimulating hormone in the blood. Evidence: PCS. Frequency: 1/1. (PMID:30489636)
- Decreased circulating inhibin B concentration (HP:0031100): The concentration of inhibin B in the blood circulation is below the lower limit of normal. Evidence: PCS. Frequency: 1/1. (PMID:30489636)
- Autosomal recessive inheritance (HP:0000007): A mode of inheritance that is observed for traits related to a gene encoded on one of the autosomes (i.e., the human chromosomes 1-22) in which a trait manifests in individuals with two pathogenic alleles, either homozygotes (two copies of the same mutant allele) or compound heterozygotes (whereby each copy of a gene has a distinct mutant allele). Evidence: PCS. (PMID:30489636)
- Decreased serum estradiol (HP:0008214): A reduction below normal concentration of estradiol in the circulation. Evidence: PCS. Frequency: 1/1. (PMID:30489636)
- Decreased circulating antimullerian hormone circulation (HP:0031103): A reduction below the normal range of the antimullerian hormone in the circulation. Evidence: PCS. Frequency: 1/1. (PMID:30489636)